- High palate (HP:0000218): Height of the palate more than 2 SD above the mean (objective) or palatal height at the level of the first permanent molar more than twice the height of the teeth (subjective). Evidence: TAS. Frequency: Very frequent (HP:0040281). (ORPHA:2792)
- Full cheeks (HP:0000293): Increased prominence or roundness of soft tissues between zygomata and mandible. Evidence: TAS. Frequency: Very frequent (HP:0040281). (ORPHA:2792)
- Facial asymmetry (HP:0000324): An abnormal difference between the left and right sides of the face. Evidence: TAS. Frequency: Occasional (HP:0040283). (ORPHA:2792)
- Macrotia (HP:0000400): Median longitudinal ear length greater than two standard deviations above the mean and median ear width greater than two standard deviations above the mean (objective); or, apparent increase in length and width of the pinna (subjective). Evidence: TAS. Frequency: Very frequent (HP:0040281). (ORPHA:2792)
- Conductive hearing impairment (HP:0000405): An abnormality of vibrational conductance of sound to the inner ear leading to impairment of sensory perception of sound. Evidence: TAS. Frequency: Very frequent (HP:0040281). (ORPHA:2792)
- Protruding ear (HP:0000411): Angle formed by the plane of the ear and the mastoid bone greater than the 97th centile for age (objective); or, outer edge of the helix more than 2 cm from the mastoid at the point of maximum distance (objective). Evidence: TAS. Frequency: Very frequent (HP:0040281). (ORPHA:2792)
- Atresia of the external auditory canal (HP:0000413): Absence or failure to form of the external auditory canal. Evidence: TAS. Frequency: Occasional (HP:0040283). (ORPHA:2792)
- Anteverted nares (HP:0000463): Anteriorly-facing nostrils viewed with the head in the Frankfurt horizontal and the eyes of the observer level with the eyes of the subject. This gives the appearance of an upturned nose (upturned nasal tip). Evidence: TAS. Frequency: Very frequent (HP:0040281). (ORPHA:2792)
- Abnormal clavicle morphology (HP:0000889): Any abnormality of the clavicles (collar bones). Evidence: TAS. Frequency: Very frequent (HP:0040281). (ORPHA:2792)
- Intellectual disability (HP:0001249): The term intellectual disability or intellectual developmental disorder is used to describe significantly sub-average intellectual and adaptive functioning based on clinical assessment and as measured by individually administered, appropriately normed, standardized and validated tests of intellectual functioning and adaptive behavior, with onset during the developmental period from infancy through adolescence. Evidence: TAS. Frequency: Very frequent (HP:0040281). (ORPHA:2792)
- Global developmental delay (HP:0001263): A delay in the achievement of motor or mental milestones in the domains of development of a child, including motor skills, speech and language, cognitive skills, and social and emotional skills. This term should only be used to describe children younger than five years of age. Evidence: TAS. Frequency: Very frequent (HP:0040281). (ORPHA:2792)
- Hypertonia (HP:0001276): A condition in which there is increased muscle tone so that arms or legs, for example, are stiff and difficult to move. Evidence: TAS. Frequency: Very frequent (HP:0040281). (ORPHA:2792)
- Hyperreflexia (HP:0001347): Hyperreflexia is the presence of hyperactive stretch reflexes of the muscles. Evidence: TAS. Frequency: Very frequent (HP:0040281). (ORPHA:2792)
- Abnormal speech pattern (HP:0002167): An abnormality in the sound (volume) or cadence (rate) of speech. Evidence: TAS. Frequency: Very frequent (HP:0040281). (ORPHA:2792)
- Delayed skeletal maturation (HP:0002750): A decreased rate of skeletal maturation. Delayed skeletal maturation can be diagnosed on the basis of an estimation of the bone age from radiographs of specific bones in the human body. Evidence: TAS. Frequency: Frequent (HP:0040282). (ORPHA:2792)
- Scapular winging (HP:0003691): Abnormal protrusion of the scapula away from the surface of the back. Evidence: TAS. Frequency: Very frequent (HP:0040281). (ORPHA:2792)
- Short stature (HP:0004322): A height below that which is expected according to age and gender norms. Although there is no universally accepted definition of short stature, many refer to "short stature" as height more than 2 standard deviations below the mean for age and gender (or below the 3rd percentile for age and gender dependent norms). Evidence: TAS. Frequency: Very frequent (HP:0040281). (ORPHA:2792)
- Preauricular pit (HP:0004467): Small indentation anterior to the insertion of the ear. Evidence: TAS. Frequency: Very frequent (HP:0040281). (ORPHA:2792)
- Depressed nasal bridge (HP:0005280): Posterior positioning of the nasal root in relation to the overall facial profile for age. Evidence: TAS. Frequency: Very frequent (HP:0040281). (ORPHA:2792)
- Abnormal dermatoglyphics (HP:0007477): An abnormality of dermatoglyphs (fingerprints), which are present on fingers, palms, toes, and soles. Evidence: TAS. Frequency: Very frequent (HP:0040281). (ORPHA:2792)
- Renal hypoplasia/aplasia (HP:0008678): Absence or underdevelopment of the kidney. Evidence: TAS. Frequency: Occasional (HP:0040283). (ORPHA:2792)
- Abnormal antihelix morphology (HP:0009738): An abnormality of the antihelix. Evidence: TAS. Frequency: Frequent (HP:0040282). (ORPHA:2792)
- Down-sloping shoulders (HP:0200021): Low set, steeply sloping shoulders. Evidence: TAS. Frequency: Very frequent (HP:0040281). (ORPHA:2792)
These phenotypes are associated with the disease Otofaciocervical syndrome (ORPHA:2792).